Phenotypes associated with the disease Mirizzi syndrome (ORPHA:521219):
- Jaundice (HP:0000952): Yellow pigmentation of the skin due to bilirubin, which in turn is the result of increased bilirubin concentration in the bloodstream. Evidence: TAS. Frequency: Frequent (HP:0040282). (ORPHA:521219)
- Cholelithiasis (HP:0001081): Hard, pebble-like deposits that form within the gallbladder. Evidence: TAS. Frequency: Frequent (HP:0040282). (ORPHA:521219)
- Abdominal pain (HP:0002027): An unpleasant sensation characterized by physical discomfort (such as pricking, throbbing, or aching) and perceived to originate in the abdomen. Evidence: TAS. Frequency: Frequent (HP:0040282). (ORPHA:521219)
- Hyperbilirubinemia (HP:0002904): An increased amount of bilirubin in the blood. Evidence: TAS. Frequency: Frequent (HP:0040282). (ORPHA:521219)
- Elevated circulating alkaline phosphatase concentration (HP:0003155): Abnormally increased serum levels of alkaline phosphatase activity. Evidence: TAS. Frequency: Frequent (HP:0040282). (ORPHA:521219)
- Cholesterol gallstones (HP:0011980): Gallstones composed primarily of cholesterol, usually about 2-3 cm in length with an oval form and a yellow or green/brown color. Evidence: TAS. Frequency: Frequent (HP:0040282). (ORPHA:521219)
- Dark urine (HP:0040319): An abnormal dark color of the urine. Evidence: TAS. Frequency: Frequent (HP:0040282). (ORPHA:521219)
- Tachycardia (HP:0001649): A rapid heartrate that exceeds the range of the normal resting heartrate for age. Evidence: TAS. Frequency: Occasional (HP:0040283). (ORPHA:521219)
- Pancreatitis (HP:0001733): The presence of inflammation in the pancreas. Evidence: TAS. Frequency: Occasional (HP:0040283). (ORPHA:521219)
- Fever (HP:0001945): Body temperature elevated above the normal range. Evidence: TAS. Frequency: Occasional (HP:0040283). (ORPHA:521219)
- Vomiting (HP:0002013): Forceful ejection of the contents of the stomach through the mouth by means of a series of involuntary spasmic contractions. Evidence: TAS. Frequency: Occasional (HP:0040283). (ORPHA:521219)
- Nausea (HP:0002018): A sensation of unease in the stomach together with an urge to vomit. Evidence: TAS. Frequency: Occasional (HP:0040283). (ORPHA:521219)
- Anorexia (HP:0002039): Lack of desire to eat (loss of appetite). Evidence: TAS. Frequency: Occasional (HP:0040283). (ORPHA:521219)
- Elevated circulating hepatic transaminase concentration (HP:0002910): Elevations of the levels of SGOT and SGPT in the serum. SGOT (serum glutamic oxaloacetic transaminase) and SGPT (serum glutamic pyruvic transaminase) are transaminases primarily found in the liver and heart and are released into the bloodstream as the result of liver or heart damage. SGOT and SGPT are used clinically mainly as markers of liver damage. Evidence: TAS. Frequency: Occasional (HP:0040283). (ORPHA:521219)
- Abdominal distention (HP:0003270): Distention of the abdomen. Evidence: TAS. Frequency: Occasional (HP:0040283). (ORPHA:521219)
- Abdominal colic (HP:0011848): A type of abdominal pain that comes and goes in waves, most often starting and ending suddenly and being of severe intensity. Evidence: TAS. Frequency: Occasional (HP:0040283). (ORPHA:521219)
- Chills (HP:0025143): A sudden sensation of feeling cold. Evidence: TAS. Frequency: Occasional (HP:0040283). (ORPHA:521219)
- Epigastric pain (HP:0410019): Pain that is localized to the region of the upper abdomen immediately below the ribs. Evidence: TAS. Frequency: Occasional (HP:0040283). (ORPHA:521219)
- Gallbladder perforation (HP:0030154): Rupture of the wall of the gallbladder. Evidence: TAS. Frequency: Very rare (HP:0040284). (ORPHA:521219)
- Abnormal ductus choledochus morphology (HP:0100889): An abnormality of the Common bile duct, a tube-like anatomic structure in the human gastrointestinal tract, formed by the union of the Common hepatic duct and the Cystic duct from the gall bladder. Evidence: TAS. Frequency: Very rare (HP:0040284). (ORPHA:521219)